Phenotypes associated with the disease optic atrophy 8 (OMIM:616648):
- Visual loss (HP:0000572): Loss of visual acuity (implying that vision was better at a certain time point in life). Otherwise the term reduced visual acuity should be used (or a subclass of that). Evidence: TAS. (OMIM:616648)
- Abnormality of pattern visual evoked potentials (HP:0030455). Evidence: PCS. (PMID:21349918)
- Abnormal auditory evoked potentials (HP:0006958): An abnormality of the auditory evoked potentials, which are used to trace the signal generated by a sound, from the cochlear nerve, through the lateral lemniscus, to the medial geniculate nucleus, and to the cortex. Evidence: IEA. Frequency: 3/5. (PMID:21349918)
- Sensorineural hearing impairment (HP:0000407): A type of hearing impairment in one or both ears related to an abnormal functionality of the cochlear nerve. Evidence: PCS. (PMID:21349918)
- Optic atrophy (HP:0000648): Atrophy of the optic nerve. Optic atrophy results from the death of the retinal ganglion cell axons that comprise the optic nerve and manifesting as a pale optic nerve on fundoscopy. Evidence: PCS. (PMID:21349918)
- Visual impairment (HP:0000505): Visual impairment (or vision impairment) is vision loss (of a person) to such a degree as to qualify as an additional support need through a significant limitation of visual capability resulting from either disease, trauma, or congenital or degenerative conditions that cannot be corrected by conventional means, such as refractive correction, medication, or surgery. Evidence: PCS. (PMID:21349918)
- Central scotoma (HP:0000603): An area of depressed vision located at the point of fixation and that interferes with central vision. Evidence: PCS. Frequency: 5/5. (PMID:21349918)
- Prolonged somatosensory evoked potentials (HP:0007104). Evidence: PCS. (PMID:21349918)
- Mitral regurgitation (HP:0001653): An abnormality of the mitral valve characterized by insufficiency or incompetence of the mitral valve resulting in retrograde leaking of blood through the mitral valve upon ventricular contraction. Evidence: TAS. Frequency: Occasional (HP:0040283). (OMIM:616648)
- Autosomal dominant inheritance (HP:0000006): A mode of inheritance that is observed for traits related to a gene encoded on one of the autosomes (i.e., the human chromosomes 1-22) in which a trait manifests in heterozygotes. In the context of medical genetics, an autosomal dominant disorder is caused when a single copy of the mutant allele is present. Males and females are affected equally, and can both transmit the disorder with a risk of 50% for each child of inheriting the mutant allele. Evidence: PCS. (PMID:21349918)
- Mitral valve prolapse (HP:0001634): One or both of the leaflets (cusps) of the mitral valve bulges back into the left atrium upon contraction of the left ventricle. Evidence: PCS. Frequency: 3/5. (PMID:21349918)